Phenotypes associated with the disease Haim-Munk syndrome (ORPHA:2342):
- Periodontitis (HP:0000704): Inflammation of the periodontium. Evidence: TAS. Frequency: Very frequent (HP:0040281). (ORPHA:2342)
- Palmoplantar keratoderma (HP:0000982): Abnormal thickening of the skin of the palms of the hands and the soles of the feet. Evidence: TAS. Frequency: Very frequent (HP:0040281). (ORPHA:2342)
- Carious teeth (HP:0000670): Caries is a multifactorial bacterial infection affecting the structure of the tooth. This term has been used to describe the presence of more than expected dental caries. Evidence: TAS. Frequency: Frequent (HP:0040282). (ORPHA:2342)
- Palmoplantar hyperkeratosis (HP:0000972): Abnormal thickening of the skin localized to the palm of the hand and the sole of the foot. Evidence: TAS. Frequency: Frequent (HP:0040282). (ORPHA:2342)
- Arachnodactyly (HP:0001166): Abnormally long and slender fingers (spider fingers). Evidence: TAS. Frequency: Frequent (HP:0040282). (ORPHA:2342)
- Pes planus (HP:0001763): A foot where the longitudinal arch of the foot is in contact with the ground or floor when the individual is standing; or, in a patient lying supine, a foot where the arch is in contact with the surface of a flat board pressed against the sole of the foot by the examiner with a pressure similar to that expected from weight bearing; or, the height of the arch is reduced. Evidence: TAS. Frequency: Frequent (HP:0040282). (ORPHA:2342)
- Onychogryphosis (HP:0001805): Onychogryphosis is a disorder of nail plate growth that is clinically characterized by an opaque, yellow-brown thickening of the nail plate with associated gross hyperkeratosis, elongation, and increased curvature. Evidence: TAS. Frequency: Frequent (HP:0040282). (ORPHA:2342)
- Acroosteolysis of distal phalanges (feet) (HP:0001870). Evidence: TAS. Frequency: Frequent (HP:0040282). (ORPHA:2342)
- Osteolytic defects of the phalanges of the hand (HP:0009771): Dissolution or degeneration of bone tissue of the phalanges of the hand. Evidence: TAS. Frequency: Frequent (HP:0040282). (ORPHA:2342)
- Dry skin (HP:0000958): Skin characterized by the lack of natural or normal moisture. Evidence: TAS. Frequency: Occasional (HP:0040283). (ORPHA:2342)
- Gait disturbance (HP:0001288): The term gait disturbance can refer to any disruption of the ability to walk. Evidence: TAS. Frequency: Occasional (HP:0040283). (ORPHA:2342)
- Recurrent skin infections (HP:0001581): Infections of the skin that happen multiple times. Evidence: TAS. Frequency: Occasional (HP:0040283). (ORPHA:2342)
- Nail pits (HP:0001803): Small (typically about 1 mm or less in size) depressions on the dorsal nail surface. Evidence: TAS. Frequency: Occasional (HP:0040283). (ORPHA:2342)
- Flexion contracture of toe (HP:0005830): One or more bent (flexed) toe joints that cannot be straightened actively or passively. Evidence: TAS. Frequency: Occasional (HP:0040283). (ORPHA:2342)
- Premature loss of primary teeth (HP:0006323): Loss of the primary (also known as deciduous) teeth before the usual age. Evidence: TAS. Frequency: Occasional (HP:0040283). (ORPHA:2342)
- Flexion contracture of finger (HP:0012785): Chronic loss of joint motion in a finger due to structural changes in non-bony tissue. Evidence: TAS. Frequency: Occasional (HP:0040283). (ORPHA:2342)
- Alveolar bone loss around teeth (HP:0410027): A decrease in the amount of alveolar bone around the root of a tooth. Evidence: TAS. Frequency: Occasional (HP:0040283). (ORPHA:2342)